Phenotypes associated with the disease Succinic semialdehyde dehydrogenase deficiency (ORPHA:22):
- Atypical behavior (HP:0000708): Atypical behavior is an abnormality in a person's actions that can be controlled or modulated by the will of the individual. While abnormal behaviors can be difficult to control, they are distinct from other abnormal actions that cannot be affected by the individual's will. Evidence: TAS. Frequency: Frequent (HP:0040282). (ORPHA:22)
- Intellectual disability (HP:0001249): The term intellectual disability or intellectual developmental disorder is used to describe significantly sub-average intellectual and adaptive functioning based on clinical assessment and as measured by individually administered, appropriately normed, standardized and validated tests of intellectual functioning and adaptive behavior, with onset during the developmental period from infancy through adolescence. Evidence: TAS. Frequency: Very frequent (HP:0040281). (ORPHA:22)
- Ataxia (HP:0001251): Ataxia refers to impaired coordination of voluntary muscle movement. Cerebellar ataxia refers to ataxia due to dysfunction of the cerebellum. This causes a variety of elementary neurological deficits including asynergy (lack of coordination between muscles, limbs and joints), dysmetria (lack of ability to judge distances that can lead to under- or overshoot in grasping movements), and dysdiadochokinesia (inability to perform rapid movements requiring antagonizing muscle groups to be switched on and off repeatedly). Evidence: TAS. Frequency: Very frequent (HP:0040281). (ORPHA:22)
- Hypotonia (HP:0001252): Hypotonia is an abnormally low muscle tone (the amount of tension or resistance to movement in a muscle). Even when relaxed, muscles have a continuous and passive partial contraction which provides some resistance to passive stretching. Hypotonia thus manifests as diminished resistance to passive stretching. Hypotonia is not the same as muscle weakness, although the two conditions can co-exist. Evidence: TAS. Frequency: Very frequent (HP:0040281). (ORPHA:22)
- Global developmental delay (HP:0001263): A delay in the achievement of motor or mental milestones in the domains of development of a child, including motor skills, speech and language, cognitive skills, and social and emotional skills. This term should only be used to describe children younger than five years of age. Evidence: TAS. Frequency: Very frequent (HP:0040281). (ORPHA:22)
- Abnormality of metabolism/homeostasis (HP:0001939). Evidence: TAS. Frequency: Very frequent (HP:0040281). (ORPHA:22)
- Bilateral tonic-clonic seizure (HP:0002069): A bilateral tonic-clonic seizure is a seizure defined by a tonic (bilateral increased tone, lasting seconds to minutes) and then a clonic (bilateral sustained rhythmic jerking) phase. Evidence: TAS. Frequency: Frequent (HP:0040282). (ORPHA:22)
- Generalized myoclonic seizure (HP:0002123): A generalized myoclonic seizure is a type of generalized motor seizure characterized by bilateral, sudden, brief (<100 ms) involuntary single or multiple contraction of muscles or muscle groups of variable topography (axial, proximal limb, distal). Myoclonus is less regularly repetitive and less sustained than is clonus. Evidence: TAS. Frequency: Frequent (HP:0040282). (ORPHA:22)
- Status epilepticus (HP:0002133): Status epilepticus is a type of prolonged seizure resulting either from the failure of the mechanisms responsible for seizure termination or from the initiation of mechanisms which lead to abnormally prolonged seizures (after time point t1). It is a condition that can have long-term consequences (after time point t2), including neuronal death, neuronal injury, and alteration of neuronal networks, depending on the type and duration of seizures. Evidence: TAS. Frequency: Frequent (HP:0040282). (ORPHA:22)